Phenotypes associated with the disease ciliary discoordination due to random ciliary orientation (OMIM:215518):
- Recurrent infections (HP:0002719): Increased susceptibility to infections as manifested by repeated bouts of infection. Evidence: IEA. (OMIM:215518)
- Abnormality of metabolism/homeostasis (HP:0001939). Evidence: IEA. (OMIM:215518)
- Autosomal recessive inheritance (HP:0000007): A mode of inheritance that is observed for traits related to a gene encoded on one of the autosomes (i.e., the human chromosomes 1-22) in which a trait manifests in individuals with two pathogenic alleles, either homozygotes (two copies of the same mutant allele) or compound heterozygotes (whereby each copy of a gene has a distinct mutant allele). Evidence: IEA. (OMIM:215518)